- Upslanted palpebral fissure (HP:0000582): The palpebral fissure inclination is more than two standard deviations above the mean for age (objective); or, the inclination of the palpebral fissure is greater than typical for age. Evidence: PCS. Frequency: 1/1. (PMID:24462883)
- Anteverted nares (HP:0000463): Anteriorly-facing nostrils viewed with the head in the Frankfurt horizontal and the eyes of the observer level with the eyes of the subject. This gives the appearance of an upturned nose (upturned nasal tip). Evidence: PCS. Frequency: 1/1. (PMID:24462883)
- Inguinal hernia (HP:0000023): Protrusion of the contents of the abdominal cavity through the inguinal canal. Evidence: TAS. (OMIM:613735)
- Renal hypoplasia (HP:0000089): Hypoplasia of the kidney. Evidence: TAS. (OMIM:613735)
- Seizure (HP:0001250): A seizure is an intermittent abnormality of nervous system physiology characterized by a transient occurrence of signs and/or symptoms due to abnormal excessive or synchronous neuronal activity in the brain. Evidence: PCS. Frequency: 0/1. (PMID:24462883)
- Syringomyelia (HP:0003396): Dilated, glial-lined cavity in spinal cord. This cavity does not communicate with the central canal, and usually is between the dorsal columns unilaterally or bilaterally along the side of the cord. Evidence: TAS. (OMIM:613735)
- Narrow mouth (HP:0000160): Distance between the commissures of the mouth more than 2 SD below the mean. Alternatively, an apparently decreased width of the oral aperture (subjective). Evidence: TAS. (OMIM:613735)
- Agenesis of corpus callosum (HP:0001274): Absence of the corpus callosum as a result of the failure of the corpus callosum to develop, which can be the result of a failure in any one of the multiple steps of callosal development including cellular proliferation and migration, axonal growth or glial patterning at the midline. Evidence: TAS. (OMIM:613735)
- Hypotonia (HP:0001252): Hypotonia is an abnormally low muscle tone (the amount of tension or resistance to movement in a muscle). Even when relaxed, muscles have a continuous and passive partial contraction which provides some resistance to passive stretching. Hypotonia thus manifests as diminished resistance to passive stretching. Hypotonia is not the same as muscle weakness, although the two conditions can co-exist. Evidence: PCS. Frequency: 1/1. (PMID:24462883)
- Short nose (HP:0003196): Distance from nasion to subnasale more than two standard deviations below the mean, or alternatively, an apparently decreased length from the nasal root to the nasal tip. Evidence: TAS. (OMIM:613735)
- Broad face (HP:0000283): Bizygomatic (upper face) and bigonial (lower face) width greater than 2 standard deviations above the mean (objective); or an apparent increase in the width of the face (subjective). Evidence: TAS. (OMIM:613735)
- Infantile onset (HP:0003593): Onset of signs or symptoms of disease between 28 days to one year of life. Evidence: PCS. Frequency: 1/1. (PMID:24462883)
- Delayed fine motor development (HP:0010862): A type of motor delay characterized by a delay in acquiring the ability to control the fingers and hands. Evidence: PCS. Frequency: 1/1. (PMID:24462883)
- Cognitive impairment (HP:0100543): Abnormal cognition is characterized by deficits in thinking, reasoning, or remembering. Evidence: TAS. (OMIM:613735)
- Failure to thrive (HP:0001508): Failure to thrive (FTT) refers to a child whose physical growth is substantially below the norm. Evidence: PCS. Frequency: 1/1. (PMID:24462883)
- Broad forehead (HP:0000337): Width of the forehead or distance between the frontotemporales is more than two standard deviations above the mean (objective); or apparently increased distance between the two sides of the forehead. Evidence: TAS. (OMIM:613735)
- Thin upper lip vermilion (HP:0000219): Height of the vermilion of the upper lip in the midline more than 2 SD below the mean. Alternatively, an apparently reduced height of the vermilion of the upper lip in the frontal view (subjective). Evidence: TAS. (OMIM:613735)
- Ventriculomegaly (HP:0002119): An increase in size of the ventricular system of the brain. Evidence: PCS. Frequency: 1/1. (PMID:24462883)
- Sporadic (HP:0003745): Cases of the disease in question occur without a previous family history, i.e., as isolated cases without being transmitted from a parent and without other siblings being affected. Evidence: TAS. (OMIM:613735)
- Macrocephaly (HP:0000256): Occipitofrontal (head) circumference greater than 97th centile compared to appropriate, age matched, sex-matched normal standards. Alternatively, a apparently increased size of the cranium. Evidence: PCS. Frequency: 1/1. (PMID:24462883)
- Intellectual disability (HP:0001249): The term intellectual disability or intellectual developmental disorder is used to describe significantly sub-average intellectual and adaptive functioning based on clinical assessment and as measured by individually administered, appropriately normed, standardized and validated tests of intellectual functioning and adaptive behavior, with onset during the developmental period from infancy through adolescence. Evidence: TAS. (OMIM:613735)
- Overfolded helix (HP:0000396): A condition in which the helix is folded over to a greater degree than normal. That is, excessive curling of the helix edge, whereby the free edge is parallel to the plane of the ear. Evidence: PCS. Frequency: 1/1. (PMID:24462883)
- Vesicoureteral reflux (HP:0000076): Abnormal (retrograde) movement of urine from the bladder into ureters or kidneys related to inadequacy of the valvular mechanism at the ureterovesicular junction or other causes. Evidence: TAS. Frequency: Frequent (HP:0040282). (OMIM:613735)
- Hypoplasia of the corpus callosum (HP:0002079): Underdevelopment of the corpus callosum. Evidence: PCS. Frequency: 1/1. (PMID:24462883)
- Short chin (HP:0000331): Decreased vertical distance from the vermilion border of the lower lip to the inferior-most point of the chin. Evidence: TAS. (OMIM:613735)
- Global developmental delay (HP:0001263): A delay in the achievement of motor or mental milestones in the domains of development of a child, including motor skills, speech and language, cognitive skills, and social and emotional skills. This term should only be used to describe children younger than five years of age. Evidence: PCS. Frequency: 1/1. (PMID:24462883)
- Delayed gross motor development (HP:0002194): A type of motor delay characterized by a delay in acquiring the ability to control the large muscles of the body for walking, running, sitting, and crawling. Evidence: PCS. Frequency: 1/1. (PMID:24462883)
- Chiari type I malformation (HP:0007099): Arnold-Chiari type I malformation refers to a relatively mild degree of herniation of the posteroinferior region of the cerebellum (the cerebellar tonsils) into the cervical canal with little or no displacement of the fourth ventricle. It is characterized by one or both pointed (not rounded) cerebellar tonsils that project 5 mm below the foramen magnum, measured by a line drawn from the basion to the opisthion (McRae Line). Evidence: PCS. Frequency: 0/1. (PMID:24462883)
- Metopic synostosis (HP:0011330): Premature fusion of the metopic suture. Evidence: PCS. Frequency: 1/1. (PMID:24462883)
- Cutis marmorata (HP:0000965): A reticular discoloration of the skin with cyanotic (reddish-blue appearing) areas surrounding pale central areas due to dilation of capillary blood vessels and stagnation of blood within the vessels. Cutis marmorata generally occurs on the legs, arms and trunk and is often more severe in cold weather. Evidence: PCS. Frequency: 1/1. (PMID:24462883)
- Autosomal dominant inheritance (HP:0000006): A mode of inheritance that is observed for traits related to a gene encoded on one of the autosomes (i.e., the human chromosomes 1-22) in which a trait manifests in heterozygotes. In the context of medical genetics, an autosomal dominant disorder is caused when a single copy of the mutant allele is present. Males and females are affected equally, and can both transmit the disorder with a risk of 50% for each child of inheriting the mutant allele. Evidence: PCS. (PMID:24462883)
- Low-set ears (HP:0000369): Upper insertion of the ear to the scalp below an imaginary horizontal line drawn between the inner canthi of the eye and extending posteriorly to the ear. Evidence: TAS. (OMIM:613735)
- Hydronephrosis (HP:0000126): Severe distention of the kidney with dilation of the renal pelvis and calices. Evidence: PCS. Frequency: 1/1. (PMID:24462883)
These phenotypes are associated with the disease brain malformations with or without urinary tract defects (OMIM:613735).